- Epistaxis (HP:0000421): Epistaxis, or nosebleed, refers to a hemorrhage localized in the nose. Evidence: TAS. Frequency: Frequent (HP:0040282). (ORPHA:326)
- Joint hemorrhage (HP:0005261): Hemorrhage occurring within a joint. Evidence: TAS. Frequency: Frequent (HP:0040282). (ORPHA:326)
- Menorrhagia (HP:0000132): Prolonged and excessive menses at regular intervals in excess of 80 mL or lasting longer than 7 days. Evidence: TAS. Frequency: Occasional (HP:0040283). (ORPHA:326)
- Gingival bleeding (HP:0000225): Hemorrhage affecting the gingiva. Evidence: TAS. Frequency: Occasional (HP:0040283). (ORPHA:326)
- Hematuria (HP:0000790): The presence of blood in the urine. Hematuria may be gross hematuria (visible to the naked eye) or microscopic hematuria (detected by dipstick or microscopic examination of the urine). Evidence: TAS. Frequency: Occasional (HP:0040283). (ORPHA:326)
- Bruising susceptibility (HP:0000978): An ecchymosis (bruise) refers to the skin discoloration caused by the escape of blood into the tissues from ruptured blood vessels. This term refers to an abnormally increased susceptibility to bruising. The corresponding phenotypic abnormality is generally elicited on medical history as a report of frequent ecchymoses or bruising without adequate trauma. Evidence: TAS. Frequency: Occasional (HP:0040283). (ORPHA:326)
- Persistent bleeding after trauma (HP:0001934). Evidence: TAS. Frequency: Occasional (HP:0040283). (ORPHA:326)
- Gastrointestinal hemorrhage (HP:0002239): Hemorrhage affecting the gastrointestinal tract. Evidence: TAS. Frequency: Occasional (HP:0040283). (ORPHA:326)
- Prolonged bleeding after surgery (HP:0004846): Bleeding that persists longer than the normal time following a surgical procedure. Evidence: TAS. Frequency: Occasional (HP:0040283). (ORPHA:326)
- Prolonged bleeding after dental extraction (HP:0006298): Prolonged bleeding post dental extraction sufficient to require medical intervention. Evidence: TAS. Frequency: Occasional (HP:0040283). (ORPHA:326)
- Spontaneous hematomas (HP:0007420): Spontaneous development of hematomas (hematoma) or bruises without significant trauma. Evidence: TAS. Frequency: Occasional (HP:0040283). (ORPHA:326)
- Prolonged bleeding following procedure (HP:0011890): Prolonged or protracted bleeding following an invasive procedure or intervention. Evidence: TAS. Frequency: Occasional (HP:0040283). (ORPHA:326)
- Post-partum hemorrhage (HP:0011891): Significant maternal hemorrhage/blood loss following deilvery of a child. Evidence: TAS. Frequency: Occasional (HP:0040283). (ORPHA:326)
- Prolonged bleeding following circumcision (HP:0030137): Bleeding that persists for a longer than usual time following circumcision. Evidence: TAS. Frequency: Occasional (HP:0040283). (ORPHA:326)
- Oral cavity bleeding (HP:0030140): Recurrent or excessive bleeding from the mouth. Evidence: TAS. Frequency: Occasional (HP:0040283). (ORPHA:326)
- Hemoptysis (HP:0002105): Coughing up (expectoration) of blood or blood-streaked sputum from the larynx, trachea, bronchi, or lungs. Evidence: TAS. Frequency: Very rare (HP:0040284). (ORPHA:326)
- Intracranial hemorrhage (HP:0002170): Hemorrhage occurring within the skull. Evidence: TAS. Frequency: Very rare (HP:0040284). (ORPHA:326)
- Hematochezia (HP:0002573): The passage of fresh (red) blood per anus, usually in or with stools. Most rectal bleeding comes from the colon, rectum, or anus. Evidence: TAS. Frequency: Very rare (HP:0040284). (ORPHA:326)
- Metrorrhagia (HP:0100608): Bleeding at irregular intervals. Evidence: TAS. Frequency: Very rare (HP:0040284). (ORPHA:326)
These phenotypes are associated with the disease Congenital factor V deficiency (ORPHA:326).